Phenotypes associated with the disease congenital disorder of glycosylation, type ICC (OMIM:301031):
- Type I transferrin isoform profile (HP:0003642): Abnormal transferrin isoform profile consistent with a type I congenital disorder of glycosylation. In the traditional nomenclature for congenital disorders of glycosylation, absence of entire glycans was designated type I, and loss of one or more monosaccharides as type II. Evidence: PCS. Frequency: 2/2. (PMID:31036665)
- X-linked recessive inheritance (HP:0001419): A mode of inheritance that is observed for recessive traits related to a gene encoded on the X chromosome. In the context of medical genetics, X-linked recessive disorders manifest in males (who have one copy of the X chromosome and are thus hemizygotes), but generally not in female heterozygotes who have one mutant and one normal allele. Evidence: PCS. (PMID:31036665)
- Global developmental delay (HP:0001263): A delay in the achievement of motor or mental milestones in the domains of development of a child, including motor skills, speech and language, cognitive skills, and social and emotional skills. This term should only be used to describe children younger than five years of age. Evidence: PCS. Frequency: 2/2. (PMID:31036665)
- Hepatomegaly (HP:0002240): Abnormally increased size of the liver. Evidence: PCS. Frequency: 1/2. (PMID:31036665)
- Intellectual disability (HP:0001249): The term intellectual disability or intellectual developmental disorder is used to describe significantly sub-average intellectual and adaptive functioning based on clinical assessment and as measured by individually administered, appropriately normed, standardized and validated tests of intellectual functioning and adaptive behavior, with onset during the developmental period from infancy through adolescence. Evidence: IEA. Frequency: 2/2. (PMID:31036665)